Phenotypes associated with the disease Acute lung injury (ORPHA:178320):
- Pneumonia (HP:0002090): Inflammation of any part of the lung parenchyma. Evidence: TAS. Frequency: Frequent (HP:0040282). (ORPHA:178320)
- Dyspnea (HP:0002094): Difficult or labored breathing. Dyspnea is a subjective feeling only the patient can rate, e.g., on a Borg scale. Evidence: TAS. Frequency: Frequent (HP:0040282). (ORPHA:178320)
- Respiratory distress (HP:0002098): Respiratory distress is objectively observable as the physical or emotional consequences from the experience of dyspnea. The physical presentation of respiratory distress is generally referred to as labored breathing, while the sensation of respiratory distress is called shortness of breath or dyspnea. Evidence: TAS. Frequency: Frequent (HP:0040282). (ORPHA:178320)
- Pulmonary infiltrates (HP:0002113). Evidence: TAS. Frequency: Frequent (HP:0040282). (ORPHA:178320)
- Tachypnea (HP:0002789): Very rapid breathing. Evidence: TAS. Frequency: Frequent (HP:0040282). (ORPHA:178320)
- Respiratory failure (HP:0002878): A severe form of respiratory insufficiency characterized by inadequate gas exchange such that the levels of oxygen or carbon dioxide cannot be maintained within normal limits. Evidence: TAS. Frequency: Frequent (HP:0040282). (ORPHA:178320)
- Abnormal circulating cytokine concentration (HP:0011112): Abnormality of the cytokine levels in the blood, i.e., an abnormality of any of the non-antibody proteins made by inflammatory leukocytes and some non-leukocytic cells that affect the behavior of other cells. Evidence: TAS. Frequency: Frequent (HP:0040282). (ORPHA:178320)
- Elevated circulating C-reactive protein concentration (HP:0011227): The concentration of C-reactive protein in the blood circulation is above the upper limit of normal. Evidence: TAS. Frequency: Frequent (HP:0040282). (ORPHA:178320)
- Hypoxemia (HP:0012418): An abnormally low level of blood oxygen. Evidence: TAS. Frequency: Frequent (HP:0040282). (ORPHA:178320)
- Increased circulating interleukin 6 concentration (HP:0030783): The concentration of interleukin-6 in the blood circulation is above the upper limit of normal. Evidence: TAS. Frequency: Frequent (HP:0040282). (ORPHA:178320)
- Elevated circulating surfactant protein concentration (HP:0032094): The concentration of surfactant protein in the blood circulation is above the upper limit of normal. Evidence: TAS. Frequency: Frequent (HP:0040282). (ORPHA:178320)
- Edema (HP:0000969): An abnormal accumulation of fluid beneath the skin, or in one or more cavities of the body. Evidence: TAS. Frequency: Occasional (HP:0040283). (ORPHA:178320)
- Acute pancreatitis (HP:0001735): A acute form of pancreatitis. Evidence: TAS. Frequency: Occasional (HP:0040283). (ORPHA:178320)
- Fever (HP:0001945): Body temperature elevated above the normal range. Evidence: TAS. Frequency: Occasional (HP:0040283). (ORPHA:178320)
- Hemoptysis (HP:0002105): Coughing up (expectoration) of blood or blood-streaked sputum from the larynx, trachea, bronchi, or lungs. Evidence: TAS. Frequency: Occasional (HP:0040283). (ORPHA:178320)
- Abnormal pulmonary interstitial morphology (HP:0006530): Abnormality of the lung parenchyma extending to the pulmonary interstitium and leading to diffuse pulmonary fibrosis. Evidence: TAS. Frequency: Occasional (HP:0040283). (ORPHA:178320)
- Abnormality of tumor necrosis factor secretion (HP:0011118): An abnormality in the production or cellular release of tumor necrosis factor. Evidence: TAS. Frequency: Occasional (HP:0040283). (ORPHA:178320)
- Diffuse alveolar hemorrhage (HP:0025420): A type of of pulmonary hemorrhage that originates from the pulmonary microcirculation, including the alveolar capillaries, arterioles, and venules. It presents with hemoptysis, anemia, diffuse lung infiltration, and acute respiratory failure. The diagnosis is confirmed by the observation of the accumulation of red blood cells, fibrin, or hemosiderin-laden macrophage in the alveolar space on pathologic biopsy. Hemosiderin, a product of hemoglobin degradation, appears at least 48-72 hours after bleeding and is helpful in distinguishing diffuse alveolar hemorrhage from surgical trauma. Mild interstitial thickening, organizing pneumonia, or diffuse alveolar damage can also be seen. Evidence: TAS. Frequency: Occasional (HP:0040283). (ORPHA:178320)
- Addictive alcohol use (HP:0030955): An addictive behavior is defined as drinking excessive amounts of alcohol over a prolonged period of time, having difficulty in reducing the amount of alcohol consumed, strongly desiring alcohol, and experiencing withdrawal symptoms when not drinking alcohol. Evidence: TAS. Frequency: Occasional (HP:0040283). (ORPHA:178320)
- Shock (HP:0031273): The state in which profound and widespread reduction of effective tissue perfusion leads first to reversible, and then if prolonged, to irreversible cellular injury. Evidence: TAS. Frequency: Occasional (HP:0040283). (ORPHA:178320)
- Sepsis (HP:0100806): Sepsis is defined as life-threatening organ dysfunction caused by a dysregulated host response to infection. Evidence: TAS. Frequency: Occasional (HP:0040283). (ORPHA:178320)